Phenotypes associated with the disease X-linked intellectual disability-hypogammaglobulinemia-progressive neurological deterioration syndrome (ORPHA:85317):
- Cleft palate (HP:0000175): Cleft palate is a developmental defect of the palate resulting from a failure of fusion of the palatine processes and manifesting as a separation of the roof of the mouth (soft and hard palate). Evidence: TAS. Frequency: Frequent (HP:0040282). (ORPHA:85317)
- Mandibular prognathia (HP:0000303): Abnormal prominence of the chin related to increased length of the mandible. Evidence: TAS. Frequency: Very frequent (HP:0040281). (ORPHA:85317)
- Hypertelorism (HP:0000316): Interpupillary distance more than 2 SD above the mean (alternatively, the appearance of an increased interpupillary distance or widely spaced eyes). Evidence: TAS. Frequency: Frequent (HP:0040282). (ORPHA:85317)
- Short philtrum (HP:0000322): Distance between nasal base and midline upper lip vermilion border more than 2 SD below the mean. Alternatively, an apparently decreased distance between nasal base and midline upper lip vermilion border. Evidence: TAS. Frequency: Frequent (HP:0040282). (ORPHA:85317)
- Prominent supraorbital ridges (HP:0000336): Greater than average forward and/or lateral protrusion of the supraorbital portion of the frontal bones. Evidence: TAS. Frequency: Frequent (HP:0040282). (ORPHA:85317)
- Protruding ear (HP:0000411): Angle formed by the plane of the ear and the mastoid bone greater than the 97th centile for age (objective); or, outer edge of the helix more than 2 cm from the mastoid at the point of maximum distance (objective). Evidence: TAS. Frequency: Frequent (HP:0040282). (ORPHA:85317)
- Synophrys (HP:0000664): Meeting of the medial eyebrows in the midline. Evidence: TAS. Frequency: Very frequent (HP:0040281). (ORPHA:85317)
- Hypertrichosis (HP:0000998): Hypertrichosis is increased hair growth that is abnormal in quantity or location. Evidence: TAS. Frequency: Very frequent (HP:0040281). (ORPHA:85317)
- Seizure (HP:0001250): A seizure is an intermittent abnormality of nervous system physiology characterized by a transient occurrence of signs and/or symptoms due to abnormal excessive or synchronous neuronal activity in the brain. Evidence: TAS. Frequency: Very frequent (HP:0040281). (ORPHA:85317)
- Ataxia (HP:0001251): Ataxia refers to impaired coordination of voluntary muscle movement. Cerebellar ataxia refers to ataxia due to dysfunction of the cerebellum. This causes a variety of elementary neurological deficits including asynergy (lack of coordination between muscles, limbs and joints), dysmetria (lack of ability to judge distances that can lead to under- or overshoot in grasping movements), and dysdiadochokinesia (inability to perform rapid movements requiring antagonizing muscle groups to be switched on and off repeatedly). Evidence: TAS. Frequency: Frequent (HP:0040282). (ORPHA:85317)
- Cerebellar atrophy (HP:0001272): Cerebellar atrophy is defined as a cerebellum with initially normal structures, in a posterior fossa with normal size, which displays enlarged fissures (interfolial spaces) in comparison to the foliae secondary to loss of tissue. Cerebellar atrophy implies irreversible loss of tissue and result from an ongoing progressive disease until a final stage is reached or a single injury, e.g. an intoxication or infectious event. Evidence: TAS. Frequency: Frequent (HP:0040282). (ORPHA:85317)
- Gait disturbance (HP:0001288): The term gait disturbance can refer to any disruption of the ability to walk. Evidence: TAS. Frequency: Frequent (HP:0040282). (ORPHA:85317)
- Muscle weakness (HP:0001324): Reduced strength of muscles. Evidence: TAS. Frequency: Frequent (HP:0040282). (ORPHA:85317)
- Moderate intellectual disability (HP:0002342): Moderate intellectual disability (ID) is defined as a type of ID characterized by moderately sub-average adaptive functioning and intellectual functioning, with an intelligence quotient (IQ) the range of 35-49. Evidence: TAS. Frequency: Very frequent (HP:0040281). (ORPHA:85317)
- Progressive neurologic deterioration (HP:0002344). Evidence: TAS. Frequency: Very frequent (HP:0040281). (ORPHA:85317)
- Scoliosis (HP:0002650): The presence of an abnormal lateral curvature of the spine. Evidence: TAS. Frequency: Frequent (HP:0040282). (ORPHA:85317)
- Kyphosis (HP:0002808): Exaggerated anterior convexity of the thoracic vertebral column. Evidence: TAS. Frequency: Frequent (HP:0040282). (ORPHA:85317)
- Decreased circulating immunoglobulin concentration (HP:0004313): An abnormally decreased level of immunoglobulin in blood. Evidence: TAS. Frequency: Very frequent (HP:0040281). (ORPHA:85317)
- Prominent metopic ridge (HP:0005487): Vertical bony ridge positioned in the midline of the forehead. Evidence: TAS. Frequency: Very frequent (HP:0040281). (ORPHA:85317)
- Bilateral single transverse palmar creases (HP:0007598): The distal and proximal transverse palmar creases are merged into a single transverse palmar crease on both hands. Evidence: TAS. Frequency: Very frequent (HP:0040281). (ORPHA:85317)
- Peripheral neuropathy (HP:0009830): Peripheral neuropathy is a general term for any disorder of the peripheral nervous system. The main clinical features used to classify peripheral neuropathy are distribution, type (mainly demyelinating versus mainly axonal), duration, and course. Evidence: TAS. Frequency: Frequent (HP:0040282). (ORPHA:85317)